Phenotypes associated with the disease tropical spastic paraparesis (OMIM:159580):
- Myelopathy (HP:0002196): Myelopathy is an descriptive term, referring to pathology leading to a neurologic deficit related to the spinal cord. The clinical diagnosis of myelopathy requires a detailed history and physical examination to define the clinical syndrome. Neuroimaging is indicated in most instances of new-onset myelopathy. It is indicated also when the worsening of a myelopathy is unexplained. Evidence: TAS. (OMIM:159580)
- Abnormal pyramidal sign (HP:0007256): Functional neurological abnormalities related to dysfunction of the pyramidal tract. Evidence: TAS. (OMIM:159580)
- Spastic paraparesis (HP:0002313): Partial loss of the ability to move the lower limbs accompanied by spasticity of the lower limbs. Evidence: TAS. (OMIM:159580)